- Small hand (HP:0200055): Disproportionately small hand. Evidence: TAS. Frequency: Very frequent (HP:0040281). (ORPHA:254531)
- Precocious puberty (HP:0000826): The onset of secondary sexual characteristics before a normal age. Although it is difficult to define normal age ranges because of the marked variation with which puberty begins in normal children, precocious puberty can be defined as the onset of puberty before the age of 8 years in girls or 9 years in boys. Evidence: TAS. Frequency: Frequent (HP:0040282). (ORPHA:254531)
- Obesity (HP:0001513): Accumulation of substantial excess body fat. Evidence: TAS. Frequency: Frequent (HP:0040282). (ORPHA:254531)
- Postnatal growth retardation (HP:0008897): Slow or limited growth after birth. Evidence: TAS. Frequency: Frequent (HP:0040282). (ORPHA:254531)
- Prominent forehead (HP:0011220): Forward prominence of the entire forehead, due to protrusion of the frontal bone. Evidence: TAS. Frequency: Frequent (HP:0040282). (ORPHA:254531)
- Feeding difficulties (HP:0011968): Impaired ability to eat related to problems gathering food and getting ready to suck, chew, or swallow it. Evidence: TAS. Frequency: Frequent (HP:0040282). (ORPHA:254531)
- High palate (HP:0000218): Height of the palate more than 2 SD above the mean (objective) or palatal height at the level of the first permanent molar more than twice the height of the teeth (subjective). Evidence: TAS. Frequency: Occasional (HP:0040283). (ORPHA:254531)
- Short philtrum (HP:0000322): Distance between nasal base and midline upper lip vermilion border more than 2 SD below the mean. Alternatively, an apparently decreased distance between nasal base and midline upper lip vermilion border. Evidence: TAS. Frequency: Occasional (HP:0040283). (ORPHA:254531)
- Micrognathia (HP:0000347): Developmental hypoplasia of the mandible. Evidence: TAS. Frequency: Occasional (HP:0040283). (ORPHA:254531)
- Recurrent otitis media (HP:0000403): Increased susceptibility to otitis media, as manifested by recurrent episodes of otitis media. Evidence: TAS. Frequency: Occasional (HP:0040283). (ORPHA:254531)
- Wide nose (HP:0000445): Interalar distance more than two standard deviations above the mean for age, i.e., an apparently increased width of the nasal base and alae. Evidence: TAS. Frequency: Occasional (HP:0040283). (ORPHA:254531)
- Autistic behavior (HP:0000729): Persistent deficits in social interaction and communication and interaction as well as a markedly restricted repertoire of activity and interest as well as repetitive patterns of behavior. Evidence: TAS. Frequency: Occasional (HP:0040283). (ORPHA:254531)
- Reduced eye contact (HP:0000817): A reduced frequency or duration of eye contact. Evidence: TAS. Frequency: Occasional (HP:0040283). (ORPHA:254531)
- Intellectual disability (HP:0001249): The term intellectual disability or intellectual developmental disorder is used to describe significantly sub-average intellectual and adaptive functioning based on clinical assessment and as measured by individually administered, appropriately normed, standardized and validated tests of intellectual functioning and adaptive behavior, with onset during the developmental period from infancy through adolescence. Evidence: TAS. Frequency: Occasional (HP:0040283). (ORPHA:254531)
- Scoliosis (HP:0002650): The presence of an abnormal lateral curvature of the spine. Evidence: TAS. Frequency: Occasional (HP:0040283). (ORPHA:254531)
- Hypercholesterolemia (HP:0003124): An increased concentration of cholesterol in the blood. Evidence: TAS. Frequency: Occasional (HP:0040283). (ORPHA:254531)
- Decreased facial expression (HP:0004673): A reduced degree of voluntary and involuntary facial movements involved in responded to others or expressing emotions. Evidence: TAS. Frequency: Occasional (HP:0040283). (ORPHA:254531)
- Maturity-onset diabetes of the young (HP:0004904): The term Maturity-onset diabetes of the young (MODY) was initially used for patients diagnosed with fasting hyperglycemia that could be treated without insulin for more than two years, where the initial diagnosis was made at a young age (under 25 years). Thus, MODY combines characteristics of type 1 diabetes (young age at diagnosis) and type 2 diabetes (less insulin dependence than type 1 diabetes). The term MODY is now most often used to refer to a group of monogenic diseases with these characteristics. Here, the term is used to describe hyperglycemia diagnosed at a young age with no or minor insulin dependency, no evidence of insulin resistance, and lack of evidence of autoimmune destruction of the beta cells. Evidence: TAS. Frequency: Occasional (HP:0040283). (ORPHA:254531)
- Poor fine motor coordination (HP:0007010): An abnormality of the ability (skills) to perform a precise movement of small muscles with the intent to perform a specific act. Fine motor skills are required to mediate movements of the wrists, hands, fingers, feet, and toes. Evidence: TAS. Frequency: Occasional (HP:0040283). (ORPHA:254531)
- Floppy infant (HP:0008947): Floppiness/hypotonia is defined as reduced resistance to passive movement of joints. Physical examination of floppy/hypotonic infants shows head lag, lack of shoulder and elbow muscle contraction on traction response, inability to tighten the shoulder girdle muscles (or slipping through) when held under the axillae, scarf sign (when the arm is pulled to the opposite side, the arm wraps around the neck with the elbow crossing midline), hyperdorsiflexion of the feet, easy apposition of the thumb against the forearm, feet touching the cheek with ease and without discomfort, frog leg position, and inverted U sign on ventral suspension (head, arms, and legs hanging down without elbow or knee flexion and the trunk rounded in a dome shape). Evidence: TAS. Frequency: Occasional (HP:0040283). (ORPHA:254531)
- Reduced social responsiveness (HP:0012760): A reduced ability to participate in the back-and-forth flow of social interaction appropriate to culture and developmental level, which is normally characterized by an influence of the behavior of one person on the behavior of another person. This results in difficulty interacting with others through emotional, physical, or verbal communication. Evidence: TAS. Frequency: Occasional (HP:0040283). (ORPHA:254531)
- Clinodactyly (HP:0030084): An angulation of a digit at an interphalangeal joint in the plane of the palm (finger) or sole (toe). Evidence: TAS. Frequency: Occasional (HP:0040283). (ORPHA:254531)
- Delayed speech and language development (HP:0000750): A degree of language development that is significantly below the norm for a child of a specified age. Evidence: TAS. Frequency: Very frequent (HP:0040281). (ORPHA:254531)
- Hypotonia (HP:0001252): Hypotonia is an abnormally low muscle tone (the amount of tension or resistance to movement in a muscle). Even when relaxed, muscles have a continuous and passive partial contraction which provides some resistance to passive stretching. Hypotonia thus manifests as diminished resistance to passive stretching. Hypotonia is not the same as muscle weakness, although the two conditions can co-exist. Evidence: TAS. Frequency: Very frequent (HP:0040281). (ORPHA:254531)
- Motor delay (HP:0001270): A type of Developmental delay characterized by a delay in acquiring motor skills. Evidence: TAS. Frequency: Very frequent (HP:0040281). (ORPHA:254531)
- Joint hypermobility (HP:0001382): The capability that a joint (or a group of joints) has to move, passively and/or actively, beyond normal limits along physiological axes. Evidence: TAS. Frequency: Very frequent (HP:0040281). (ORPHA:254531)
- Intrauterine growth retardation (HP:0001511): An abnormal restriction of fetal growth with fetal weight below the tenth percentile for gestational age. Evidence: TAS. Frequency: Very frequent (HP:0040281). (ORPHA:254531)
- Short foot (HP:0001773): A measured foot length that is more than 2 SD below the mean for a newborn of 27 - 41 weeks gestation, or foot that is less than the 3rd centile for individuals from birth to 16 years of age (objective). Alternatively, a foot that appears disproportionately short (subjective). Evidence: TAS. Frequency: Very frequent (HP:0040281). (ORPHA:254531)
These phenotypes are associated with the disease Temple syndrome due to paternal 14q32.2 hypomethylation (ORPHA:254531).